- Abnormality of the eye (HP:0000478): Any abnormality of the eye, including location, spacing, and intraocular abnormalities. Evidence: TAS. Frequency: Very frequent (HP:0040281). (ORPHA:2253)
- Strabismus (HP:0000486): A misalignment of the eyes so that the visual axes deviate from bifoveal fixation. The classification of strabismus may be based on a number of features including the relative position of the eyes, whether the deviation is latent or manifest, intermittent or constant, concomitant or otherwise and according to the age of onset and the relevance of any associated refractive error. Evidence: TAS. Frequency: Frequent (HP:0040282). (ORPHA:2253)
- Cataract (HP:0000518): A cataract is an opacity or clouding that develops in the crystalline lens of the eye or in its capsule. Evidence: TAS. Frequency: Very frequent (HP:0040281). (ORPHA:2253)
- Nystagmus (HP:0000639): Rhythmic, involuntary oscillations of one or both eyes related to abnormality in fixation, conjugate gaze, or vestibular mechanisms. Evidence: TAS. Frequency: Very frequent (HP:0040281). (ORPHA:2253)
- Optic atrophy (HP:0000648): Atrophy of the optic nerve. Optic atrophy results from the death of the retinal ganglion cell axons that comprise the optic nerve and manifesting as a pale optic nerve on fundoscopy. Evidence: TAS. Frequency: Very frequent (HP:0040281). (ORPHA:2253)
- Abnormality of vision (HP:0000504): Abnormality of eyesight (visual perception). Evidence: TAS. Frequency: Very frequent (HP:0040281). (ORPHA:2253)
- Generalized hyperpigmentation (HP:0007440). Evidence: TAS. Frequency: Very frequent (HP:0040281). (ORPHA:2253)
These phenotypes are associated with the disease Foveal hypoplasia-presenile cataract syndrome (ORPHA:2253).